Phenotypes associated with the disease Mantle cell lymphoma (ORPHA:52416):
- Splenomegaly (HP:0001744): Abnormal increased size of the spleen. Evidence: TAS. Frequency: Frequent (HP:0040282). (ORPHA:52416)
- Weight loss (HP:0001824): Reduction of total body weight. Evidence: TAS. Frequency: Frequent (HP:0040282). (ORPHA:52416)
- Anorexia (HP:0002039): Lack of desire to eat (loss of appetite). Evidence: TAS. Frequency: Frequent (HP:0040282). (ORPHA:52416)
- Lymphadenopathy (HP:0002716): Enlargement (swelling) of a lymph node. Evidence: TAS. Frequency: Very frequent (HP:0040281). (ORPHA:52416)
- Abnormal bone marrow cell morphology (HP:0005561): An anomaly of the form or number of cells in the bone marrow. Evidence: TAS. Frequency: Frequent (HP:0040282). (ORPHA:52416)
- Abnormality of the gastrointestinal tract (HP:0011024): An abnormality of the gastrointestinal tract. Evidence: TAS. Frequency: Occasional (HP:0040283). (ORPHA:52416)
- Fatigue (HP:0012378): A subjective feeling of tiredness characterized by a lack of energy and motivation. Evidence: TAS. Frequency: Frequent (HP:0040282). (ORPHA:52416)
- Fever (HP:0001945): Body temperature elevated above the normal range. Evidence: TAS. Frequency: Frequent (HP:0040282). (ORPHA:52416)
- B-cell lymphoma (HP:0012191): A type of lymphoma that originates in B-cells. Evidence: TAS. Frequency: Very frequent (HP:0040281). (ORPHA:52416)